- Fever (HP:0001945): Body temperature elevated above the normal range. Evidence: TAS. Frequency: Very frequent (HP:0040281). (ORPHA:810)
- Abdominal pain (HP:0002027): An unpleasant sensation characterized by physical discomfort (such as pricking, throbbing, or aching) and perceived to originate in the abdomen. Evidence: TAS. Frequency: Very frequent (HP:0040281). (ORPHA:810)
- Bloody mucoid diarrhea (HP:0025086): Passage of many stools containing blood and mucus. Evidence: TAS. Frequency: Very frequent (HP:0040281). (ORPHA:810)
- Abdominal cramps (HP:0032155): A type of abdominal pain characterized by a feeling of contractions and typically fluctuating in intensity. Evidence: TAS. Frequency: Very frequent (HP:0040281). (ORPHA:810)
- Dehydration (HP:0001944). Evidence: TAS. Frequency: Frequent (HP:0040282). (ORPHA:810)
- Increased total leukocyte count (HP:0001974): An abnormal increase in the number of leukocytes in the blood. Evidence: TAS. Frequency: Frequent (HP:0040282). (ORPHA:810)
- Vomiting (HP:0002013): Forceful ejection of the contents of the stomach through the mouth by means of a series of involuntary spasmic contractions. Evidence: TAS. Frequency: Frequent (HP:0040282). (ORPHA:810)
- Nausea (HP:0002018): A sensation of unease in the stomach together with an urge to vomit. Evidence: TAS. Frequency: Frequent (HP:0040282). (ORPHA:810)
- Anorexia (HP:0002039): Lack of desire to eat (loss of appetite). Evidence: TAS. Frequency: Frequent (HP:0040282). (ORPHA:810)
- Abnormal circulating electrolyte concentration (HP:0003111): Abnormality of the homeostasis (concentration) of a monoatomic ion. Evidence: TAS. Frequency: Frequent (HP:0040282). (ORPHA:810)
- Fatigue (HP:0012378): A subjective feeling of tiredness characterized by a lack of energy and motivation. Evidence: TAS. Frequency: Frequent (HP:0040282). (ORPHA:810)
- Tenesmus (HP:0012702): A repeated, painful urge to defecate without excreting stool. Evidence: TAS. Frequency: Frequent (HP:0040282). (ORPHA:810)
- Asthenia (HP:0025406): A state characterized by a feeling of weakness and loss of strength leading to a generalized weakness of the body. Evidence: TAS. Frequency: Frequent (HP:0040282). (ORPHA:810)
- Failure to thrive in infancy (HP:0001531). Evidence: TAS. Frequency: Occasional (HP:0040283). (ORPHA:810)
- Hypoglycemia (HP:0001943): A decreased concentration of glucose in the blood. Evidence: TAS. Frequency: Occasional (HP:0040283). (ORPHA:810)
- Febrile seizure (within the age range of 3 months to 6 years) (HP:0002373): A febrile seizure is any type of seizure (most often a generalized tonic-clonic seizure) occurring with fever (at least 38 degrees Celsius) but in the absence of central nervous system infection, severe metabolic disturbance or other alternative precipitant in children between the ages of 3 months and 6 years. Evidence: TAS. Frequency: Occasional (HP:0040283). (ORPHA:810)
- Paralytic ileus (HP:0002590). Evidence: TAS. Frequency: Occasional (HP:0040283). (ORPHA:810)
- Immunodeficiency (HP:0002721): Failure of the immune system to protect the body adequately from infection, due to the absence or insufficiency of some component process or substance. Evidence: TAS. Frequency: Occasional (HP:0040283). (ORPHA:810)
- Hyponatremia (HP:0002902): The concentration of sodium in the blood circulation is below the lower limit of normal. Evidence: TAS. Frequency: Occasional (HP:0040283). (ORPHA:810)
- Bloody diarrhea (HP:0025085): Passage of many stools containing blood. Evidence: TAS. Frequency: Occasional (HP:0040283). (ORPHA:810)
- Abscess (HP:0025615): An abscess is a localized collection of purulent material surrounded by inflammation and granulation. Evidence: TAS. Frequency: Occasional (HP:0040283). (ORPHA:810)
- Hypovolemic shock (HP:0031274): A state of shock characterized by decreased circulating blood volume in relation to total vascular capacity. This type of shock is characterized by a reduction of diastolic filling pressures. Evidence: TAS. Frequency: Occasional (HP:0040283). (ORPHA:810)
- Ulcerative colitis (HP:0100279): A chronic inflammatory bowel disease that includes characteristic ulcers, or open sores, in the colon. The main symptom of active disease is usually constant diarrhea mixed with blood, of gradual onset and intermittent periods of exacerbated symptoms contrasting with periods that are relatively symptom-free. In contrast to Crohn's disease this special form of colitis begins in the distal parts of the rectum, spreads continually upwards and affects only mucose and submucose tissue of the colon. Evidence: TAS. Frequency: Occasional (HP:0040283). (ORPHA:810)
- Acute colitis (HP:0100282): An acute and self-limited inflammatory disease of the large intestine (colon, cecum and rectum). Evidence: TAS. Frequency: Occasional (HP:0040283). (ORPHA:810)
- Conjunctivitis (HP:0000509): Inflammation of the conjunctiva. Evidence: TAS. Frequency: Very rare (HP:0040284). (ORPHA:810)
- Uveitis (HP:0000554): Inflammation of one or all portions of the uveal tract. Evidence: TAS. Frequency: Very rare (HP:0040284). (ORPHA:810)
- Purpura (HP:0000979): Purpura (from Latin: purpura, meaning purple) is the appearance of red or purple discolorations on the skin that do not blanch on applying pressure. They are caused by bleeding underneath the skin. This term refers to an abnormally increased susceptibility to developing purpura. Purpura are larger than petechiae. Evidence: TAS. Frequency: Very rare (HP:0040284). (ORPHA:810)
- Urticaria (HP:0001025): Raised, well-circumscribed areas of erythema and edema involving the dermis and epidermis. Urticaria is intensely pruritic, and blanches completely with pressure. Evidence: TAS. Frequency: Very rare (HP:0040284). (ORPHA:810)
- Arthritis (HP:0001369): Inflammation of a joint. Evidence: TAS. Frequency: Very rare (HP:0040284). (ORPHA:810)
- Cholestasis (HP:0001396): Impairment of bile flow due to obstruction in bile ducts. Evidence: TAS. Frequency: Very rare (HP:0040284). (ORPHA:810)
- Hepatic failure (HP:0001399). Evidence: TAS. Frequency: Very rare (HP:0040284). (ORPHA:810)
- Thrombocytopenia (HP:0001873): A reduction in the number of circulating thrombocytes. Evidence: TAS. Frequency: Very rare (HP:0040284). (ORPHA:810)
- Acute kidney injury (HP:0001919): Sudden loss of renal function, as manifested by decreased urine production, and a rise in serum creatinine or blood urea nitrogen concentration (azotemia). Evidence: TAS. Frequency: Very rare (HP:0040284). (ORPHA:810)
- Microangiopathic hemolytic anemia (HP:0001937). Evidence: TAS. Frequency: Very rare (HP:0040284). (ORPHA:810)
- Pneumonia (HP:0002090): Inflammation of any part of the lung parenchyma. Evidence: TAS. Frequency: Very rare (HP:0040284). (ORPHA:810)
- Peritonitis (HP:0002586): Inflammation of the peritoneum. Evidence: TAS. Frequency: Very rare (HP:0040284). (ORPHA:810)
- Rhabdomyolysis (HP:0003201): Breakdown of muscle fibers that leads to the release of muscle fiber contents (myoglobin) into the bloodstream. Evidence: TAS. Frequency: Very rare (HP:0040284). (ORPHA:810)
- Hemolytic-uremic syndrome (HP:0005575): A thrombotic microangiopathy with presence of non-immune, intravascular hemolytic anemia, thrombocytopenia and acute kidney injury. A vicious cycle of complement activation, endothelial cell damage, platelet activation, and thrombosis is the hallmark of the disease. Evidence: TAS. Frequency: Very rare (HP:0040284). (ORPHA:810)
- Peripheral neuropathy (HP:0009830): Peripheral neuropathy is a general term for any disorder of the peripheral nervous system. The main clinical features used to classify peripheral neuropathy are distribution, type (mainly demyelinating versus mainly axonal), duration, and course. Evidence: TAS. Frequency: Very rare (HP:0040284). (ORPHA:810)
- Corneal ulceration (HP:0012804): Disruption of the epithelial layer of the cornea with involvement of the underlying stroma. Evidence: TAS. Frequency: Very rare (HP:0040284). (ORPHA:810)
- Myocarditis (HP:0012819): Inflammation of the myocardium. Evidence: TAS. Frequency: Very rare (HP:0040284). (ORPHA:810)
- Splenic abscess (HP:0025059): A circumscribed area of pus or necrotic debris in the parenchyma of the spleen. Evidence: TAS. Frequency: Very rare (HP:0040284). (ORPHA:810)
- Intestinal perforation (HP:0031368): A hole (perforation) in the wall of the intestine. Evidence: TAS. Frequency: Very rare (HP:0040284). (ORPHA:810)
- Bacteremia (HP:0031864): Presence of viable bacteria in the blood. Evidence: TAS. Frequency: Very rare (HP:0040284). (ORPHA:810)
- Sepsis (HP:0100806): Sepsis is defined as life-threatening organ dysfunction caused by a dysregulated host response to infection. Evidence: TAS. Frequency: Very rare (HP:0040284). (ORPHA:810)
- Urethritis (HP:0500006): Inflammation of the urethra. Evidence: TAS. Frequency: Very rare (HP:0040284). (ORPHA:810)
These phenotypes are associated with the disease Shigellosis (ORPHA:810).